- Increased serum bile acid concentration during pregnancy (HP:0200150). Evidence: TAS. (OMIM:614972)
- Abnormal liver function tests during pregnancy (HP:0200148). Evidence: TAS. (OMIM:614972)
- Autosomal recessive inheritance (HP:0000007): A mode of inheritance that is observed for traits related to a gene encoded on one of the autosomes (i.e., the human chromosomes 1-22) in which a trait manifests in individuals with two pathogenic alleles, either homozygotes (two copies of the same mutant allele) or compound heterozygotes (whereby each copy of a gene has a distinct mutant allele). Evidence: TAS. Frequency: Occasional (HP:0040283). (OMIM:614972)
- Pruritus (HP:0000989): Pruritus is an itch or a sensation that makes a person want to scratch. This term refers to an abnormally increased disposition to experience pruritus. Evidence: TAS. (OMIM:614972)
- Intrahepatic cholestasis (HP:0001406): Impairment of bile flow due to obstruction in the small bile ducts within the liver. Evidence: TAS. (OMIM:614972)
- Fetal distress (HP:0025116): An intrauterine state characterized by suboptimal values in the fetal heart rate, oxygenation of fetal blood, or other parameters indicative of compromise of the fetus. Signs of fetal distress include repetitive variable decelerations, fetal tachycardia or bradycardia, late decelerations, or low biophysical profile. Evidence: TAS. (OMIM:614972)
- Autosomal dominant inheritance (HP:0000006): A mode of inheritance that is observed for traits related to a gene encoded on one of the autosomes (i.e., the human chromosomes 1-22) in which a trait manifests in heterozygotes. In the context of medical genetics, an autosomal dominant disorder is caused when a single copy of the mutant allele is present. Males and females are affected equally, and can both transmit the disorder with a risk of 50% for each child of inheriting the mutant allele. Evidence: TAS. (OMIM:614972)
- Jaundice (HP:0000952): Yellow pigmentation of the skin due to bilirubin, which in turn is the result of increased bilirubin concentration in the bloodstream. Evidence: TAS. Frequency: Occasional (HP:0040283). (OMIM:614972)
- Premature birth (HP:0001622): The birth of a baby of less than 37 weeks of gestational age. Evidence: TAS. (OMIM:614972)
These phenotypes are associated with the disease cholestasis, intrahepatic, of pregnancy, 3 (OMIM:614972).